- Recurrent viral infections (HP:0004429): Increased susceptibility to viral infections as manifested by recurrent episodes of viral infection. Evidence: IEA. (OMIM:120050)
This phenotype is associated with the disease Coxsackievirus B3 susceptibility (OMIM:120050).